Phenotypes associated with the disease Postpoliomyelitis syndrome (ORPHA:2942):
- Muscle weakness (HP:0001324): Reduced strength of muscles. Evidence: TAS. Frequency: Very frequent (HP:0040281). (ORPHA:2942)
- Pain (HP:0012531): An unpleasant sensory and emotional experience associated with actual or potential tissue damage, or described in terms of such damage. Evidence: TAS. Frequency: Very frequent (HP:0040281). (ORPHA:2942)
- Arthralgia (HP:0002829): Joint pain. Evidence: TAS. Frequency: Frequent (HP:0040282). (ORPHA:2942)
- Myalgia (HP:0003326): Pain in muscle. Evidence: TAS. Frequency: Frequent (HP:0040282). (ORPHA:2942)
- Difficulty climbing stairs (HP:0003551): Reduced ability to climb stairs. Evidence: TAS. Frequency: Frequent (HP:0040282). (ORPHA:2942)
- Abnormality of mental function (HP:0011446): Cognitive, psychiatric, or memory anomaly. Evidence: TAS. Frequency: Frequent (HP:0040282). (ORPHA:2942)
- Fatigue (HP:0012378): A subjective feeling of tiredness characterized by a lack of energy and motivation. Evidence: TAS. Frequency: Frequent (HP:0040282). (ORPHA:2942)
- Excessive daytime somnolence (HP:0001262): A state of abnormally strong desire for sleep during the daytime. Evidence: TAS. Frequency: Frequent (HP:0040282). (ORPHA:2942)
- Dysarthria (HP:0001260): Dysarthric speech is a general description referring to a neurological speech disorder characterized by poor articulation. Depending on the involved neurological structures, dysarthria may be further classified as spastic, flaccid, ataxic, hyperkinetic and hypokinetic, or mixed. Evidence: TAS. Frequency: Occasional (HP:0040283). (ORPHA:2942)
- Abnormal joint morphology (HP:0001367): An abnormal structure or form of the joints, i.e., one or more of the articulations where two bones join. Evidence: TAS. Frequency: Occasional (HP:0040283). (ORPHA:2942)
- Dysphagia (HP:0002015): Difficulty in swallowing. Evidence: TAS. Frequency: Occasional (HP:0040283). (ORPHA:2942)
- Respiratory insufficiency (HP:0002093). Evidence: TAS. Frequency: Occasional (HP:0040283). (ORPHA:2942)
- Sleep disturbance (HP:0002360): An abnormal pattern in the quality, quantity, or characteristics of sleep. Evidence: TAS. Frequency: Occasional (HP:0040283). (ORPHA:2942)
- Fasciculations (HP:0002380): Fasciculations are observed as small, local, involuntary muscle contractions (twitching) visible under the skin. Fasciculations result from increased irritability of an axon (which in turn is often a manifestation of disease of a motor neuron). This leads to sporadic discharges of all the muscle fibers controlled by the axon in isolation from other motor units. Evidence: TAS. Frequency: Occasional (HP:0040283). (ORPHA:2942)
- Skeletal muscle atrophy (HP:0003202): The presence of skeletal muscular atrophy (which is also known as amyotrophy). Evidence: TAS. Frequency: Occasional (HP:0040283). (ORPHA:2942)
- Muscle spasm (HP:0003394): Sudden and involuntary contractions of one or more muscles. Evidence: TAS. Frequency: Occasional (HP:0040283). (ORPHA:2942)
- Hypoventilation (HP:0002791): A reduction in the amount of air transported into the pulmonary alveoli by breathing, leading to hypercapnia (increase in the partial pressure of carbon dioxide). Evidence: TAS. Frequency: Very rare (HP:0040284). (ORPHA:2942)